Phenotypes associated with the disease Retinal dystrophy, reticular pigmentary, of posterior pole (OMIM:267800):
- Reticular pigmentary degeneration (HP:0007937): A pattern of peripheral netlike retinal pigmentation that forms a polygonal arrangement of hyperpigmented lines forming geometric patterns in the fundus. Evidence: TAS. (OMIM:267800)
- Autosomal recessive inheritance (HP:0000007): A mode of inheritance that is observed for traits related to a gene encoded on one of the autosomes (i.e., the human chromosomes 1-22) in which a trait manifests in individuals with two pathogenic alleles, either homozygotes (two copies of the same mutant allele) or compound heterozygotes (whereby each copy of a gene has a distinct mutant allele). Evidence: TAS. (OMIM:267800)
- Drusen (HP:0011510): Drusen (singular, 'druse') are tiny yellow or white accumulations of extracellular material (lipofuscin) that build up in the Bruch membrane of the eye. Evidence: TAS. (OMIM:267800)
- Retinal dystrophy (HP:0000556): Retinal dystrophy is an abnormality of the retina associated with a hereditary process. Retinal dystrophies are defined by their predominantly monogenic inheritance and they are frequently associated with loss or dysfunction of photoreceptor cells as a primary or secondary event. Evidence: TAS. (OMIM:267800)